- Juvenile onset (HP:0003621, a Human Phenotype Ontology term): Onset of signs or symptoms of disease between the age of 5 and 15 years. Evidence: PCS. Frequency: 3/5. (PMID:38950288)
- Mildly reduced left ventricular ejection fraction (HP:0012663, a Human Phenotype Ontology term): A small reduction in the fraction of blood pumped from the left ventricle with each cardiac cycle. The normal range in adults is at least 50 percent, and a mild reduction is defined as 40-49 percent. Evidence: PCS. Frequency: 2/5. (PMID:38950288)
- Young adult onset (HP:0011462, a Human Phenotype Ontology term): Onset of disease at the age of between 16 and 40 years. Evidence: PCS. Frequency: 2/5. (PMID:38950288)
- Left ventricular noncompaction cardiomyopathy (HP:0011664, a Human Phenotype Ontology term): Left ventricular non-compaction (LVNC) is characterized by prominent left ventricular trabeculae and deep inter-trabecular recesses. The myocardial wall is often thickened with a thin, compacted epicardial layer and a thickened endocardial layer. In some patients, LVNC is associated with left ventricular dilatation and systolic dysfunction, which can be transient in neonates. Evidence: PCS. Frequency: 2/5. (PMID:38950288)
- Severely reduced left ventricular ejection fraction (HP:0012666, a Human Phenotype Ontology term): A large reduction in the fraction of blood pumped from the left ventricle with each cardiac cycle. The normal range in adults is at over 50 percent, and a severe reduction is defined as less than 30 percent. Evidence: PCS. Frequency: 1/5. (PMID:38950288)
- Autosomal dominant inheritance (HP:0000006, a Human Phenotype Ontology term): A mode of inheritance that is observed for traits related to a gene encoded on one of the autosomes (i.e., the human chromosomes 1-22) in which a trait manifests in heterozygotes. In the context of medical genetics, an autosomal dominant disorder is caused when a single copy of the mutant allele is present. Males and females are affected equally, and can both transmit the disorder with a risk of 50% for each child of inheriting the mutant allele. Evidence: PCS. (PMID:38950288)
- Dilated cardiomyopathy (HP:0001644, a Human Phenotype Ontology term): Dilated cardiomyopathy (DCM) is defined by the presence of left ventricular dilatation and left ventricular systolic dysfunction in the absence of abnormal loading conditions (hypertension, valve disease) or coronary artery disease sufficient to cause global systolic impairment. Right ventricular dilation and dysfunction may be present but are not necessary for the diagnosis. Evidence: PCS. Frequency: 5/5. (PMID:38950288)
- Elevated left ventricular end-diastolic diameter (HP:0034307, a Human Phenotype Ontology term): The LV end-diastolic internal diameter was measured from two-dimensional (2D) images in the parasternal long-axis view, timed with mitral valve closure at the level of the mitral valve chordae. Evidence: PCS. Frequency: 5/5. (PMID:38950288)
These phenotypes are associated with the disease cardiomyopathy, dilated, 1QQ (OMIM:621251, an entry in Online Mendelian Inheritance in Man).